- Facial hypertrichosis (HP:0002219): Excessive, increased hair growth located in the facial region. Evidence: IEA. (OMIM:134000)
- Autosomal dominant inheritance (HP:0000006): A mode of inheritance that is observed for traits related to a gene encoded on one of the autosomes (i.e., the human chromosomes 1-22) in which a trait manifests in heterozygotes. In the context of medical genetics, an autosomal dominant disorder is caused when a single copy of the mutant allele is present. Males and females are affected equally, and can both transmit the disorder with a risk of 50% for each child of inheriting the mutant allele. Evidence: IEA. (OMIM:134000)
These phenotypes are associated with the disease FACIAL HYPERTRICHOSIS (OMIM:134000).